- Facial hypotonia (HP:0000297, a Human Phenotype Ontology term): Reduced muscle tone of a muscle that is innervated by the facial nerve (the seventh cranial nerve). Evidence: IEA. (OMIM:618383)
- Microcephaly (HP:0000252, a Human Phenotype Ontology term): Head circumference below 2 standard deviations below the mean for age and gender. Evidence: PCS. Frequency: 5/9. (PMID:29893856)
- Moderate intellectual disability (HP:0002342, a Human Phenotype Ontology term): Moderate intellectual disability (ID) is defined as a type of ID characterized by moderately sub-average adaptive functioning and intellectual functioning, with an intelligence quotient (IQ) the range of 35-49. Evidence: PCS. Frequency: 9/9. (PMID:29893856)
- Delayed speech and language development (HP:0000750, a Human Phenotype Ontology term): A degree of language development that is significantly below the norm for a child of a specified age. Evidence: PCS. Frequency: 9/9. (PMID:29893856)
- Cerebellar hypoplasia (HP:0001321, a Human Phenotype Ontology term): Cerebellar hypoplasia is a descriptive term implying a cerebellum with a reduced volume, but a normal shape and is stable over time. Evidence: PCS. Frequency: 1/3. (PMID:29893856)
- Delayed ability to walk (HP:0031936, a Human Phenotype Ontology term): A failure to achieve the ability to walk at an appropriate developmental stage. Most children learn to walk in a series of stages, and learn to walk short distances independently between 12 and 15 months. Evidence: PCS. Frequency: 2/3. (PMID:29893856)
- Dysarthria (HP:0001260, a Human Phenotype Ontology term): Dysarthric speech is a general description referring to a neurological speech disorder characterized by poor articulation. Depending on the involved neurological structures, dysarthria may be further classified as spastic, flaccid, ataxic, hyperkinetic and hypokinetic, or mixed. Evidence: IEA. (OMIM:618383)
- Global developmental delay (HP:0001263, a Human Phenotype Ontology term): A delay in the achievement of motor or mental milestones in the domains of development of a child, including motor skills, speech and language, cognitive skills, and social and emotional skills. This term should only be used to describe children younger than five years of age. Evidence: PCS. (PMID:29893856)
- Hypotonia (HP:0001252, a Human Phenotype Ontology term): Hypotonia is an abnormally low muscle tone (the amount of tension or resistance to movement in a muscle). Even when relaxed, muscles have a continuous and passive partial contraction which provides some resistance to passive stretching. Hypotonia thus manifests as diminished resistance to passive stretching. Hypotonia is not the same as muscle weakness, although the two conditions can co-exist. Evidence: PCS. Frequency: 1/4. (PMID:29893856)
- Ataxia (HP:0001251, a Human Phenotype Ontology term): Ataxia refers to impaired coordination of voluntary muscle movement. Cerebellar ataxia refers to ataxia due to dysfunction of the cerebellum. This causes a variety of elementary neurological deficits including asynergy (lack of coordination between muscles, limbs and joints), dysmetria (lack of ability to judge distances that can lead to under- or overshoot in grasping movements), and dysdiadochokinesia (inability to perform rapid movements requiring antagonizing muscle groups to be switched on and off repeatedly). Evidence: PCS. Frequency: 4/4. (PMID:29893856)
- Autosomal recessive inheritance (HP:0000007, a Human Phenotype Ontology term): A mode of inheritance that is observed for traits related to a gene encoded on one of the autosomes (i.e., the human chromosomes 1-22) in which a trait manifests in individuals with two pathogenic alleles, either homozygotes (two copies of the same mutant allele) or compound heterozygotes (whereby each copy of a gene has a distinct mutant allele). Evidence: PCS. (PMID:29893856)
- Hyperplasia of the maxilla (HP:0430028, a Human Phenotype Ontology term): Abnormally increased dimension of the maxilla, especially relative to the mandible, resulting in a malocclusion or malalignment between the upper and lower teeth or in anterior positioning of the nasal base, increased convexity of the face, increased nasolabial angle, or increased width (transverse dimension of the maxilla. Evidence: IEA. (OMIM:618383)
- Ventriculomegaly (HP:0002119, a Human Phenotype Ontology term): An increase in size of the ventricular system of the brain. Evidence: PCS. Frequency: 1/3. (PMID:29893856)
- Drooling (HP:0002307, a Human Phenotype Ontology term): Habitual flow of saliva out of the mouth. Evidence: PCS. Frequency: 3/3. (PMID:29893856)
- Spasticity (HP:0001257, a Human Phenotype Ontology term): A motor disorder characterized by a velocity-dependent increase in tonic stretch reflexes with increased muscle tone, exaggerated (hyperexcitable) tendon reflexes. Evidence: PCS. Frequency: 3/3. (PMID:29893856)
These phenotypes are associated with the disease intellectual developmental disorder, autosomal recessive 69 (OMIM:618383, an entry in Online Mendelian Inheritance in Man).